Phenotypes associated with the disease migraine with or without aura, susceptibility to, 6 (OMIM:607516):
- Hemiplegia (HP:0002301): Paralysis (complete loss of muscle function) in the arm, leg, and in some cases the face on one side of the body. Evidence: IEA. (OMIM:607516)
- Vomiting (HP:0002013): Forceful ejection of the contents of the stomach through the mouth by means of a series of involuntary spasmic contractions. Evidence: IEA. (OMIM:607516)
- Migraine with aura (HP:0002077): A type of migraine in which there is an aura characterized by focal neurological phenomena that usually proceed, but may accompany or occur in the absence of, the headache. The symptoms of an aura may include fully reversible visual, sensory, and speech symptoms but not motor weakness. Visual symptoms may include flickering lights, spots and lines and/or loss of vision and/or unilateral sensory symptoms such as paresthesias or numbness. At least one of the symptoms of an aura develops gradually over 5 or more minutes and/or different symptoms occur in succession. Evidence: IEA. (OMIM:607516)
- Photophobia (HP:0000613): Excessive sensitivity to light with the sensation of discomfort or pain in the eyes due to exposure to bright light. Evidence: IEA. (OMIM:607516)
- Migraine without aura (HP:0002083): Repeated headache attacks lasting 4-72 h fulfilling at least two of the following criteria: 1) unilateral location, 2) pulsating quality, 3) moderate or severe pain intensity, and 4) aggravation by or causing avoidance of routine physical activity such as climbing stairs. Headache attacks are commonly accompanied by nausea, vomiting, photophobia, or phonophobia. Evidence: IEA. (OMIM:607516)
- Phonophobia (HP:0002183): An abnormally heightened sensitivity to loud sounds. Evidence: IEA. (OMIM:607516)
- Hemiparesis (HP:0001269): Loss of strength in the arm, leg, and sometimes face on one side of the body. Hemiplegia refers to a complete loss of strength, whereas hemiparesis refers to an incomplete loss of strength. Evidence: IEA. (OMIM:607516)
- Nausea (HP:0002018): A sensation of unease in the stomach together with an urge to vomit. Evidence: IEA. (OMIM:607516)
- Autosomal dominant inheritance (HP:0000006): A mode of inheritance that is observed for traits related to a gene encoded on one of the autosomes (i.e., the human chromosomes 1-22) in which a trait manifests in heterozygotes. In the context of medical genetics, an autosomal dominant disorder is caused when a single copy of the mutant allele is present. Males and females are affected equally, and can both transmit the disorder with a risk of 50% for each child of inheriting the mutant allele. Evidence: IEA. (OMIM:607516)